- Autosomal recessive inheritance (HP:0000007): A mode of inheritance that is observed for traits related to a gene encoded on one of the autosomes (i.e., the human chromosomes 1-22) in which a trait manifests in individuals with two pathogenic alleles, either homozygotes (two copies of the same mutant allele) or compound heterozygotes (whereby each copy of a gene has a distinct mutant allele). Evidence: PCS. (PMID:19888295)
- Prelingual sensorineural hearing impairment (HP:0000399): A form of sensorineural deafness with either congenital onset or infantile onset, i.e., before the acquisition of speech. Evidence: PCS. (PMID:19888295)
These phenotypes are associated with the disease autosomal recessive nonsyndromic hearing loss 83 (OMIM:613685).